- Abnormality of blood and blood-forming tissues (HP:0001871): An abnormality of the hematopoietic system. Evidence: IEA. (OMIM:142470)
- Autosomal dominant inheritance (HP:0000006): A mode of inheritance that is observed for traits related to a gene encoded on one of the autosomes (i.e., the human chromosomes 1-22) in which a trait manifests in heterozygotes. In the context of medical genetics, an autosomal dominant disorder is caused when a single copy of the mutant allele is present. Males and females are affected equally, and can both transmit the disorder with a risk of 50% for each child of inheriting the mutant allele. Evidence: IEA. (OMIM:142470)
These phenotypes are associated with the disease FETAL HEMOGLOBIN QUANTITATIVE TRAIT LOCUS 2 (OMIM:142470).